Phenotypes associated with the disease Horizontal gaze palsy with progressive scoliosis (ORPHA:2744):
- Scoliosis (HP:0002650): The presence of an abnormal lateral curvature of the spine. Evidence: TAS. Frequency: Very frequent (HP:0040281). (ORPHA:2744)
- Kyphosis (HP:0002808): Exaggerated anterior convexity of the thoracic vertebral column. Evidence: TAS. Frequency: Very frequent (HP:0040281). (ORPHA:2744)
- Horizontal supranuclear gaze palsy (HP:0007817): A supranuclear gaze palsy is an inability to look in a horizontal direction as a result of cerebral impairment. There is a loss of the voluntary aspect of eye movements, but, as the brainstem is still intact, all the reflex conjugate eye movements are normal. Evidence: TAS. Frequency: Very frequent (HP:0040281). (ORPHA:2744)
- Microcephaly (HP:0000252): Head circumference below 2 standard deviations below the mean for age and gender. Evidence: TAS. Frequency: Frequent (HP:0040282). (ORPHA:2744)
- Short neck (HP:0000470): Diminished length of the neck. Evidence: TAS. Frequency: Frequent (HP:0040282). (ORPHA:2744)
- Strabismus (HP:0000486): A misalignment of the eyes so that the visual axes deviate from bifoveal fixation. The classification of strabismus may be based on a number of features including the relative position of the eyes, whether the deviation is latent or manifest, intermittent or constant, concomitant or otherwise and according to the age of onset and the relevance of any associated refractive error. Evidence: TAS. Frequency: Frequent (HP:0040282). (ORPHA:2744)
- Visual impairment (HP:0000505): Visual impairment (or vision impairment) is vision loss (of a person) to such a degree as to qualify as an additional support need through a significant limitation of visual capability resulting from either disease, trauma, or congenital or degenerative conditions that cannot be corrected by conventional means, such as refractive correction, medication, or surgery. Evidence: TAS. Frequency: Frequent (HP:0040282). (ORPHA:2744)
- Nystagmus (HP:0000639): Rhythmic, involuntary oscillations of one or both eyes related to abnormality in fixation, conjugate gaze, or vestibular mechanisms. Evidence: TAS. Frequency: Frequent (HP:0040282). (ORPHA:2744)
- Hypotonia (HP:0001252): Hypotonia is an abnormally low muscle tone (the amount of tension or resistance to movement in a muscle). Even when relaxed, muscles have a continuous and passive partial contraction which provides some resistance to passive stretching. Hypotonia thus manifests as diminished resistance to passive stretching. Hypotonia is not the same as muscle weakness, although the two conditions can co-exist. Evidence: TAS. Frequency: Frequent (HP:0040282). (ORPHA:2744)
- Delayed skeletal maturation (HP:0002750): A decreased rate of skeletal maturation. Delayed skeletal maturation can be diagnosed on the basis of an estimation of the bone age from radiographs of specific bones in the human body. Evidence: TAS. Frequency: Frequent (HP:0040282). (ORPHA:2744)
- Myopathy (HP:0003198): A disorder of muscle unrelated to impairment of innervation or neuromuscular junction. Evidence: TAS. Frequency: Frequent (HP:0040282). (ORPHA:2744)
- Proportionate short stature (HP:0003508): A kind of short stature in which different regions of the body are shortened to a comparable extent. Evidence: TAS. Frequency: Frequent (HP:0040282). (ORPHA:2744)
- Duane anomaly (HP:0009921): A condition associated with a limitation of the horizontal ocular movement with retraction of the globe and narrowing of the palpebral fissure on adduction. Evidence: TAS. Frequency: Frequent (HP:0040282). (ORPHA:2744)
- Cognitive impairment (HP:0100543): Abnormal cognition is characterized by deficits in thinking, reasoning, or remembering. Evidence: TAS. Frequency: Frequent (HP:0040282). (ORPHA:2744)
- Sensorineural hearing impairment (HP:0000407): A type of hearing impairment in one or both ears related to an abnormal functionality of the cochlear nerve. Evidence: TAS. Frequency: Occasional (HP:0040283). (ORPHA:2744)
- Seizure (HP:0001250): A seizure is an intermittent abnormality of nervous system physiology characterized by a transient occurrence of signs and/or symptoms due to abnormal excessive or synchronous neuronal activity in the brain. Evidence: TAS. Frequency: Occasional (HP:0040283). (ORPHA:2744)